- Acrocyanosis (HP:0001063): Bluish discoloration of the skin of the hands or feet. Evidence: TAS. Frequency: Very frequent (HP:0040281). (ORPHA:86918)
- Diffuse palmoplantar hyperkeratosis (HP:0007447): Diffuse abnormal thickening of the skin on the palms and soles. Evidence: TAS. Frequency: Very frequent (HP:0040281). (ORPHA:86918)
These phenotypes are associated with the disease Diffuse palmoplantar keratoderma-acrocyanosis syndrome (ORPHA:86918).